Phenotypes associated with the disease Episodic ataxia type 7 (ORPHA:209970):
- Dysarthria (HP:0001260): Dysarthric speech is a general description referring to a neurological speech disorder characterized by poor articulation. Depending on the involved neurological structures, dysarthria may be further classified as spastic, flaccid, ataxic, hyperkinetic and hypokinetic, or mixed. Evidence: TAS. Frequency: Very frequent (HP:0040281). (ORPHA:209970)
- Muscle weakness (HP:0001324): Reduced strength of muscles. Evidence: TAS. Frequency: Very frequent (HP:0040281). (ORPHA:209970)
- Episodic ataxia (HP:0002131): Periodic spells of incoordination and imbalance, that is, episodes of ataxia typically lasting from 10 minutes to several hours or days. Evidence: TAS. Frequency: Very frequent (HP:0040281). (ORPHA:209970)
- Vertigo (HP:0002321): An abnormal sensation of spinning while the body is actually stationary. Evidence: TAS. Frequency: Very frequent (HP:0040281). (ORPHA:209970)
- Nystagmus (HP:0000639): Rhythmic, involuntary oscillations of one or both eyes related to abnormality in fixation, conjugate gaze, or vestibular mechanisms. Evidence: TAS. Frequency: Frequent (HP:0040282). (ORPHA:209970)
- Tinnitus (HP:0000360): Tinnitus is an auditory perception that can be described as the experience of sound, in the ear or in the head, in the absence of external acoustic stimulation. Evidence: TAS. Frequency: Occasional (HP:0040283). (ORPHA:209970)
- Diplopia (HP:0000651): Diplopia is a condition in which a single object is perceived as two images, it is also known as double vision. Evidence: TAS. Frequency: Occasional (HP:0040283). (ORPHA:209970)
- Migraine (HP:0002076): Migraine is a chronic neurological disorder characterized by episodic attacks of headache and associated symptoms. Evidence: TAS. Frequency: Occasional (HP:0040283). (ORPHA:209970)
- Myokymia (HP:0002411): Myokymia consists of involuntary, fine, continuous, undulating contractions that spread across the affected striated muscle. Evidence: TAS. Frequency: Occasional (HP:0040283). (ORPHA:209970)
- Hyperkinetic movements (HP:0002487): Motor hyperactivity with excessive movement of muscles of the body as a whole. Evidence: TAS. Frequency: Occasional (HP:0040283). (ORPHA:209970)
- Cognitive impairment (HP:0100543): Abnormal cognition is characterized by deficits in thinking, reasoning, or remembering. Evidence: TAS. Frequency: Occasional (HP:0040283). (ORPHA:209970)